Phenotypes associated with the disease median nodule of the upper lip (OMIM:151630):
- Abnormality of the mouth (HP:0000153): An abnormality of the mouth. Evidence: IEA. (OMIM:151630)
- Autosomal dominant inheritance (HP:0000006): A mode of inheritance that is observed for traits related to a gene encoded on one of the autosomes (i.e., the human chromosomes 1-22) in which a trait manifests in heterozygotes. In the context of medical genetics, an autosomal dominant disorder is caused when a single copy of the mutant allele is present. Males and females are affected equally, and can both transmit the disorder with a risk of 50% for each child of inheriting the mutant allele. Evidence: IEA. (OMIM:151630)